- Resting tremor (HP:0002322): A resting tremor occurs when muscles are at rest and becomes less noticeable or disappears when the affected muscles are moved. Resting tremors are often slow and coarse. Evidence: PCS. (PMID:18358451)
- Bradykinesia (HP:0002067): Bradykinesia literally means slow movement, and is used clinically to denote a slowness in the execution of movement (in contrast to hypokinesia, which is used to refer to slowness in the initiation of movement). Evidence: PCS. (PMID:18358451)
- Rigidity (HP:0002063): Continuous involuntary sustained muscle contraction. When an affected muscle is passively stretched, the degree of resistance remains constant regardless of the rate at which the muscle is stretched. This feature helps to distinguish rigidity from muscle spasticity. Evidence: PCS. (PMID:18358451)
- Postural instability (HP:0002172): A tendency to fall or the inability to keep oneself from falling; imbalance. The retropulsion test is widely regarded as the gold standard to evaluate postural instability, Use of the retropulsion test includes a rapid balance perturbation in the backward direction, and the number of balance correcting steps (or total absence thereof) is used to rate the degree of postural instability. Healthy subjects correct such perturbations with either one or two large steps, or without taking any steps, hinging rapidly at the hips while swinging the arms forward as a counterweight. In patients with balance impairment, balance correcting steps are often too small, forcing patients to take more than two steps. Taking three or more steps is generally considered to be abnormal, and taking more than five steps is regarded as being clearly abnormal. Markedly affected patients continue to step backward without ever regaining their balance and must be caught by the examiner (this would be called true retropulsion). Even more severely affected patients fail to correct entirely, and fall backward like a pushed toy soldier, without taking any corrective steps. Evidence: PCS. (PMID:18358451)
- Parkinsonism with favorable response to dopaminergic medication (HP:0002548): Parkinsonism is a clinical syndrome that is a feature of a number of different diseases, including Parkinson disease itself, other neurodegenerative diseases such as progressive supranuclear palsy, and as a side-effect of some neuroleptic medications. Some but not all individuals with Parkinsonism show responsiveness to dopaminergic medication defined as a substantial reduction of amelioration of the component signs of Parkinsonism (including mainly tremor, bradykinesia, rigidity, and postural instability) upon administration of dopaminergic medication. Evidence: PCS. (PMID:18358451)
- Autosomal dominant inheritance (HP:0000006): A mode of inheritance that is observed for traits related to a gene encoded on one of the autosomes (i.e., the human chromosomes 1-22) in which a trait manifests in heterozygotes. In the context of medical genetics, an autosomal dominant disorder is caused when a single copy of the mutant allele is present. Males and females are affected equally, and can both transmit the disorder with a risk of 50% for each child of inheriting the mutant allele. Evidence: PCS. (PMID:18358451)
These phenotypes are associated with the disease Parkinson disease 11, autosomal dominant, susceptibility to (OMIM:607688).